Phenotypes associated with the disease retinitis pigmentosa 47 (OMIM:613758):
- Nyctalopia (HP:0000662): Inability to see well at night or in poor light. Evidence: PCS. (PMID:9565049)
- Pigmentary retinopathy (HP:0000580): An abnormality of the retina characterized by pigment deposition. It is typically associated with migration and proliferation of macrophages or retinal pigment epithelial cells into the retina; melanin from these cells causes the pigmentary changes. Pigmentary retinopathy is a common final pathway of many retinal conditions and is often associated with visual loss. Evidence: PCS. (PMID:9565049)
- Autosomal recessive inheritance (HP:0000007): A mode of inheritance that is observed for traits related to a gene encoded on one of the autosomes (i.e., the human chromosomes 1-22) in which a trait manifests in individuals with two pathogenic alleles, either homozygotes (two copies of the same mutant allele) or compound heterozygotes (whereby each copy of a gene has a distinct mutant allele). Evidence: PCS. (PMID:9565049)
- Visual impairment (HP:0000505): Visual impairment (or vision impairment) is vision loss (of a person) to such a degree as to qualify as an additional support need through a significant limitation of visual capability resulting from either disease, trauma, or congenital or degenerative conditions that cannot be corrected by conventional means, such as refractive correction, medication, or surgery. Evidence: PCS. (PMID:9565049)
- Rod-cone dystrophy (HP:0000510): An inherited retinal disease subtype in which the rod photoreceptors appear to be more severely affected than the cone photoreceptors. Typical presentation is with nyctalopia (due to rod dysfunction) followed by loss of mid-peripheral field of vision, which gradually extends and leaves many patients with a small central island of vision due to the preservation of macular cones. Evidence: PCS. (PMID:9565049)
- Chorioretinal atrophy (HP:0000533): Atrophy (wasting) of the choroid and retinal layers of the fundus. Evidence: PCS. (PMID:9565049)
- Decreased light- and dark-adapted electroretinogram amplitude (HP:0000654): Decreased amplitude of eletrical response upon electroretinography. Evidence: PCS. (PMID:9565049)